Phenotypes associated with the disease cataract 36 (OMIM:613887):
- Cataract (HP:0000518): A cataract is an opacity or clouding that develops in the crystalline lens of the eye or in its capsule. Evidence: TAS. Onset: Congenital onset (HP:0003577). (OMIM:613887)
- Autosomal recessive inheritance (HP:0000007): A mode of inheritance that is observed for traits related to a gene encoded on one of the autosomes (i.e., the human chromosomes 1-22) in which a trait manifests in individuals with two pathogenic alleles, either homozygotes (two copies of the same mutant allele) or compound heterozygotes (whereby each copy of a gene has a distinct mutant allele). Evidence: TAS. (OMIM:613887)